Phenotypes associated with the disease Familial hyperaldosteronism type III (ORPHA:251274):
- Hypertension (HP:0000822): The presence of chronic increased pressure in the systemic arterial system. Evidence: TAS. Frequency: Obligate (HP:0040280). (ORPHA:251274)
- Abnormal circulating renin concentration (HP:0040084): A deviation from the normal concentration of renin in the blood, a central hormone in the control of blood pressure and various other physiological functions. Evidence: TAS. Frequency: Obligate (HP:0040280). (ORPHA:251274)
- Hypokalemia (HP:0002900): The concentration of potassium(1+) in the blood circulation is below the lower limit of normal. Evidence: TAS. Frequency: Very frequent (HP:0040281). (ORPHA:251274)
- Adrenal hyperplasia (HP:0008221): Enlargement of the adrenal gland. Evidence: TAS. Frequency: Very frequent (HP:0040281). (ORPHA:251274)
- Glucocortocoid-insensitive primary hyperaldosteronism (HP:0011740): A form of primary hyperaldosteronism in which the overproduction of aldosterone cannot be suppressed by the administration of dexamethasone or similar glucocorticoids. Evidence: TAS. Frequency: Very frequent (HP:0040281). (ORPHA:251274)
- Tinnitus (HP:0000360): Tinnitus is an auditory perception that can be described as the experience of sound, in the ear or in the head, in the absence of external acoustic stimulation. Evidence: TAS. Frequency: Occasional (HP:0040283). (ORPHA:251274)
- Epistaxis (HP:0000421): Epistaxis, or nosebleed, refers to a hemorrhage localized in the nose. Evidence: TAS. Frequency: Occasional (HP:0040283). (ORPHA:251274)
- Muscle weakness (HP:0001324): Reduced strength of muscles. Evidence: TAS. Frequency: Occasional (HP:0040283). (ORPHA:251274)
- Prolonged QT interval (HP:0001657): Increased time between the start of the Q wave and the end of the T wave as measured by the electrocardiogram (EKG). Evidence: TAS. Frequency: Occasional (HP:0040283). (ORPHA:251274)
- Left ventricular hypertrophy (HP:0001712): Enlargement or increased size of the heart left ventricle. Evidence: TAS. Frequency: Occasional (HP:0040283). (ORPHA:251274)
- Polydipsia (HP:0001959): Excessive thirst manifested by excessive fluid intake. Evidence: TAS. Frequency: Occasional (HP:0040283). (ORPHA:251274)
- Nausea (HP:0002018): A sensation of unease in the stomach together with an urge to vomit. Evidence: TAS. Frequency: Occasional (HP:0040283). (ORPHA:251274)
- Hypercalciuria (HP:0002150). Evidence: TAS. Frequency: Occasional (HP:0040283). (ORPHA:251274)
- Intracranial hemorrhage (HP:0002170): Hemorrhage occurring within the skull. Evidence: TAS. Frequency: Occasional (HP:0040283). (ORPHA:251274)
- Headache (HP:0002315): Cephalgia, or pain sensed in various parts of the head, not confined to the area of distribution of any nerve. Evidence: TAS. Frequency: Occasional (HP:0040283). (ORPHA:251274)
- Metabolic alkalosis (HP:0200114): Metabolic alkalosis is defined as a disease state where the pH is elevated to greater than 7.45 secondary to some metabolic process. Evidence: TAS. Frequency: Occasional (HP:0040283). (ORPHA:251274)
Not associated with this disease:
- Dexamethasone-suppressible primary hyperaldosteronism (HP:0011739): A form of primary hyperaldosteronism in which the overproduction of aldosterone can be suppressed by the administration of dexamethasone. Evidence: TAS. (ORPHA:251274)